Phenotypes associated with the disease Amoebiasis due to free-living amoebae (ORPHA:68):
- Photophobia (HP:0000613): Excessive sensitivity to light with the sensation of discomfort or pain in the eyes due to exposure to bright light. Evidence: TAS. Frequency: Frequent (HP:0040282). (ORPHA:68)
- Atypical behavior (HP:0000708): Atypical behavior is an abnormality in a person's actions that can be controlled or modulated by the will of the individual. While abnormal behaviors can be difficult to control, they are distinct from other abnormal actions that cannot be affected by the individual's will. Evidence: TAS. Frequency: Frequent (HP:0040282). (ORPHA:68)
- Personality changes (HP:0000751): An abnormal shift in patterns of thinking, acting, or feeling. Evidence: TAS. Frequency: Frequent (HP:0040282). (ORPHA:68)
- Seizure (HP:0001250): A seizure is an intermittent abnormality of nervous system physiology characterized by a transient occurrence of signs and/or symptoms due to abnormal excessive or synchronous neuronal activity in the brain. Evidence: TAS. Frequency: Frequent (HP:0040282). (ORPHA:68)
- Fever (HP:0001945): Body temperature elevated above the normal range. Evidence: TAS. Frequency: Frequent (HP:0040282). (ORPHA:68)
- Vomiting (HP:0002013): Forceful ejection of the contents of the stomach through the mouth by means of a series of involuntary spasmic contractions. Evidence: TAS. Frequency: Frequent (HP:0040282). (ORPHA:68)
- Nausea (HP:0002018): A sensation of unease in the stomach together with an urge to vomit. Evidence: TAS. Frequency: Frequent (HP:0040282). (ORPHA:68)
- Headache (HP:0002315): Cephalgia, or pain sensed in various parts of the head, not confined to the area of distribution of any nerve. Evidence: TAS. Frequency: Frequent (HP:0040282). (ORPHA:68)
- Infectious encephalitis (HP:0002383): A disorder of the brain caused by an infectious agent that presents with fever, headache, and an altered level of consciousness. There may also be focal or multifocal neurologic deficits, and focal or generalized seizure activity. Evidence: TAS. Frequency: Frequent (HP:0040282). (ORPHA:68)
- Abnormal cerebrospinal fluid morphology (HP:0002921): An abnormality of the cerebrospinal fluid (CSF). Evidence: TAS. Frequency: Frequent (HP:0040282). (ORPHA:68)
- Increased CSF protein concentration (HP:0002922): Increased concentration of protein in the cerebrospinal fluid. Evidence: TAS. Frequency: Frequent (HP:0040282). (ORPHA:68)
- CSF lymphocytic pleiocytosis (HP:0200149): An increased lymphocyte count in the cerebrospinal fluid. Evidence: TAS. Frequency: Frequent (HP:0040282). (ORPHA:68)
- Brain imaging abnormality (HP:0410263): An anomaly of metabolism or structure of the brain identified by imaging. Evidence: TAS. Frequency: Frequent (HP:0040282). (ORPHA:68)
- Facial asymmetry (HP:0000324): An abnormal difference between the left and right sides of the face. Evidence: TAS. Frequency: Occasional (HP:0040283). (ORPHA:68)
- Visual loss (HP:0000572): Loss of visual acuity (implying that vision was better at a certain time point in life). Otherwise the term reduced visual acuity should be used (or a subclass of that). Evidence: TAS. Frequency: Occasional (HP:0040283). (ORPHA:68)
- Diplopia (HP:0000651): Diplopia is a condition in which a single object is perceived as two images, it is also known as double vision. Evidence: TAS. Frequency: Occasional (HP:0040283). (ORPHA:68)
- Restlessness (HP:0000711): A state of unease is characterized by diffuse motor activity or motion, which is subject to limited control, nonproductive, or disorganized behavior. Evidence: TAS. Frequency: Occasional (HP:0040283). (ORPHA:68)
- Irritability (HP:0000737): An emotional state characterized by negative feelings of heightened frustration, annoyance, or feeling upset, often triggered by internal factors (e.g., fatigue, hunger, unfulfilled desires) or external factors (e.g., social or environmental challenges). Irritability may be unpredictable, and is accompanied by a lowered threshold for emotional reactivity and observable features (speech, facial expressions, or psychomotor activity). Evidence: TAS. Frequency: Occasional (HP:0040283). (ORPHA:68)
- Lethargy (HP:0001254): A state of fatigue, either physical or mental slowness and sluggishness, with difficulties in initiating or performing simple tasks. Distinguished from apathy which implies indifference and a lack of desire or interest in the task. A person with lethargy may have the desire, but not the energy to engage in personal or socially relevant tasks. Evidence: TAS. Frequency: Occasional (HP:0040283). (ORPHA:68)
- Hemiparesis (HP:0001269): Loss of strength in the arm, leg, and sometimes face on one side of the body. Hemiplegia refers to a complete loss of strength, whereas hemiparesis refers to an incomplete loss of strength. Evidence: TAS. Frequency: Occasional (HP:0040283). (ORPHA:68)
- Confusion (HP:0001289): Lack of clarity and coherence of thought, perception, understanding, or action. Evidence: TAS. Frequency: Occasional (HP:0040283). (ORPHA:68)
- Abnormal cerebellum morphology (HP:0001317): Any structural abnormality of the cerebellum. Evidence: TAS. Frequency: Occasional (HP:0040283). (ORPHA:68)
- Abnormal basal ganglia morphology (HP:0002134): Abnormality of the basal ganglia. Evidence: TAS. Frequency: Occasional (HP:0040283). (ORPHA:68)
- Abnormal spinal cord morphology (HP:0002143): A structural abnormality of the spinal cord (myelon). Evidence: TAS. Frequency: Occasional (HP:0040283). (ORPHA:68)
- Cerebral edema (HP:0002181): Abnormal accumulation of fluid in the brain. Evidence: TAS. Frequency: Occasional (HP:0040283). (ORPHA:68)
- Aphasia (HP:0002381): An acquired language impairment of some or all of the abilities to produce or comprehend speech and to read or write. Evidence: TAS. Frequency: Occasional (HP:0040283). (ORPHA:68)
- Abnormal midbrain morphology (HP:0002418): An abnormality of the midbrain, which has as its parts the tectum, cerebral peduncle, midbrain tegmentum and cerebral aqueduct. Evidence: TAS. Frequency: Occasional (HP:0040283). (ORPHA:68)
- Abnormal cerebral white matter morphology (HP:0002500): An abnormality of the cerebral white matter. Evidence: TAS. Frequency: Occasional (HP:0040283). (ORPHA:68)
- Increased intracranial pressure (HP:0002516): An increase of the pressure inside the cranium (skull) and thereby in the brain tissue and cerebrospinal fluid. Evidence: TAS. Frequency: Occasional (HP:0040283). (ORPHA:68)
- Abnormal cerebral cortex morphology (HP:0002538): Any structural abnormality of the cerebral cortex. Evidence: TAS. Frequency: Occasional (HP:0040283). (ORPHA:68)
- Immunodeficiency (HP:0002721): Failure of the immune system to protect the body adequately from infection, due to the absence or insufficiency of some component process or substance. Evidence: TAS. Frequency: Occasional (HP:0040283). (ORPHA:68)
- Abducens palsy (HP:0006897): Malfunction of the abducens nerve as manifested by impairment of the ability of the affected eye to be moved outward. Patients who develop abducens nerve palsy often present with binocular horizontal diplopia, which is a double vision when looking at objects side by side. There will be a notable weakness of the ipsilateral lateral rectus muscle leading to a deficit in of eye abduction on the affected side. Some patients may present with a constant head turning movement to maintain binocular fusion and to lessen the degree of diplopia. Evidence: TAS. Frequency: Occasional (HP:0040283). (ORPHA:68)
- Fourth cranial nerve palsy (HP:0007011): Paralysis of the fourth cranial (trochlear) nerve manifested as weakness of the superior oblique muscle which causes vertical diplopia that is maximal when the affected eye is adducted and directed inferiorly. Evidence: TAS. Frequency: Occasional (HP:0040283). (ORPHA:68)
- Loss of consciousness (HP:0007185): Loss of awareness of oneself or one's surroundings, involving (i) a loss of normal motor control is evident as flaccidity or stiffness, either of which can be accompanied by jerking movements, and postural control is lost so that patients fall if they are in an upright position; (ii) normal responsiveness is lost; and (iii) the patient experiences amnesia for the event. Loss of consciousness my be transitory (e.g., syncope) or prolonged. Evidence: TAS. Frequency: Occasional (HP:0040283). (ORPHA:68)
- Abnormal pons morphology (HP:0007361): A structural abnormality of the pons. Evidence: TAS. Frequency: Occasional (HP:0040283). (ORPHA:68)
- Facial palsy (HP:0010628): Facial nerve palsy is a dysfunction of cranial nerve VII (the facial nerve) that results in inability to control facial muscles on the affected side with weakness of the muscles of facial expression and eye closure. This can either be present in unilateral or bilateral form. Evidence: TAS. Frequency: Occasional (HP:0040283). (ORPHA:68)
- Abnormal medulla oblongata morphology (HP:0011441): An abnormality of the medulla oblongata, the lower half of the brainstem. Evidence: TAS. Frequency: Occasional (HP:0040283). (ORPHA:68)
- Oculomotor nerve palsy (HP:0012246): Reduced ability to control the movement of the eye associated with damage to the third cranial nerve (the oculomotor nerve). Evidence: TAS. Frequency: Occasional (HP:0040283). (ORPHA:68)
- Abnormal hypothalamus morphology (HP:0012286): Any structural anomaly of the hypothalamus. Evidence: TAS. Frequency: Occasional (HP:0040283). (ORPHA:68)
- Abnormal brainstem MRI signal intensity (HP:0012747): A deviation from normal signal on magnetic resonance imaging (MRI) of the brainstem. Evidence: TAS. Frequency: Occasional (HP:0040283). (ORPHA:68)
- Increased red blood cell count (HP:0020059): An abnormal elevation above the normal number of red blood cells per volume in the circulation. Evidence: TAS. Frequency: Occasional (HP:0040283). (ORPHA:68)
- Stiff neck (HP:0025258): A sensation of tightness in the neck when attempting to move it, especially after a period of inactivity. Neck stiffness often involves soreness and difficulty moving the neck, especially when trying to turn the head to the side. Evidence: TAS. Frequency: Occasional (HP:0040283). (ORPHA:68)
- Nuchal rigidity (HP:0031179): Resistance of the extensor muscles of the neck to being bent forwards (i.e., impaired neck flexion) as a result of muscle spasm of the extensor muscles of the neck. Nuchal rigidity is not a fixed rigidity. Nuchal rigidity has been used as a bedside test for meningism, although its sensitivity for this purpose has been debated. Evidence: TAS. Frequency: Occasional (HP:0040283). (ORPHA:68)
- Abnormal cranial nerve physiology (HP:0031910): A functional abnormality affecting one or more of the cranial nerves, which emerge directly from the brain stem. Evidence: TAS. Frequency: Occasional (HP:0040283). (ORPHA:68)
- Granuloma (HP:0032252): A compact, organized collection of mature mononuclear phagocytes, which may be but is not necessarily accompanied by accessory features such as necrosis. Evidence: TAS. Frequency: Occasional (HP:0040283). (ORPHA:68)
- Abnormality of taste sensation (HP:0000223). Evidence: TAS. Frequency: Very rare (HP:0040284). (ORPHA:68)
- Sinusitis (HP:0000246): Inflammation of the paranasal sinuses owing to a viral, bacterial, or fungal infection, allergy, or an autoimmune reaction. Evidence: TAS. Frequency: Very rare (HP:0040284). (ORPHA:68)
- Blindness (HP:0000618): Blindness is the condition of lacking visual perception defined as a profound reduction in visual perception. On the 6m visual acuity scale, blindness is defined as less than 3/60. On the 20ft visual acuity scale, blindness is defined as less than 20/400. On the decimal visual acuity scale, blindness is defined as less than 0.05. Blindness is typically characterized by a visual field of no greater than 10 degrees in radius around central fixation. Evidence: TAS. Frequency: Very rare (HP:0040284). (ORPHA:68)
- Abnormality of the adrenal glands (HP:0000834): Abnormality of the adrenal glands, i.e., of the endocrine glands located at the top of the kindneys. Evidence: TAS. Frequency: Very rare (HP:0040284). (ORPHA:68)
- Ataxia (HP:0001251): Ataxia refers to impaired coordination of voluntary muscle movement. Cerebellar ataxia refers to ataxia due to dysfunction of the cerebellum. This causes a variety of elementary neurological deficits including asynergy (lack of coordination between muscles, limbs and joints), dysmetria (lack of ability to judge distances that can lead to under- or overshoot in grasping movements), and dysdiadochokinesia (inability to perform rapid movements requiring antagonizing muscle groups to be switched on and off repeatedly). Evidence: TAS. Frequency: Very rare (HP:0040284). (ORPHA:68)
- Coma (HP:0001259): The complete absence of wakefulness and consciousness, which is evident through a lack of response to any form of external stimuli. Evidence: TAS. Frequency: Very rare (HP:0040284). (ORPHA:68)
- Subcutaneous nodule (HP:0001482): Slightly elevated lesions on or in the skin with a diameter of over 5 mm. Evidence: TAS. Frequency: Very rare (HP:0040284). (ORPHA:68)
- Myocardial necrosis (HP:0001700): Irreversible damage to heart tissue (myocardium) due to lack of oxygen after a heart attack (myocardial infarction). Evidence: TAS. Frequency: Very rare (HP:0040284). (ORPHA:68)
- Pneumonia (HP:0002090): Inflammation of any part of the lung parenchyma. Evidence: TAS. Frequency: Very rare (HP:0040284). (ORPHA:68)
- Hyposmia (HP:0004409): A decreased sensitivity to odorants (that is, a decreased ability to perceive odors). Evidence: TAS. Frequency: Very rare (HP:0040284). (ORPHA:68)
- Arrhythmia (HP:0011675): Any cardiac rhythm other than the normal sinus rhythm. Such a rhythm may be either of sinus or ectopic origin and either regular or irregular. An arrhythmia may be due to a disturbance in impulse formation or conduction or both. Evidence: TAS. Frequency: Very rare (HP:0040284). (ORPHA:68)
- Respiratory tract infection (HP:0011947): An infection of the upper or lower respiratory tract. Evidence: TAS. Frequency: Very rare (HP:0040284). (ORPHA:68)
- Corneal ulceration (HP:0012804): Disruption of the epithelial layer of the cornea with involvement of the underlying stroma. Evidence: TAS. Frequency: Very rare (HP:0040284). (ORPHA:68)
- Conjunctival hyperemia (HP:0030953): Dilatation of the blood vessels of the conjunctiva leading to a red appearance of the sclera. Evidence: TAS. Frequency: Very rare (HP:0040284). (ORPHA:68)
- Increased tear production (HP:0031731): Increased lacrimation owing to overproduction of tears. Evidence: TAS. Frequency: Very rare (HP:0040284). (ORPHA:68)
- Unusual skin infection (HP:0032162): Increased susceptibility to infection of the skin, nails, or mucous membranes, as manifested by recurrent or severe cutaneous or mucosal infection, or by skin or mucous membrane infection caused by an atypical or opportunistic organism. Evidence: TAS. Frequency: Very rare (HP:0040284). (ORPHA:68)
- Intrarenal abscess (HP:0032620): An encapsulated collection of pus and necrotic material within the renal parenchyma. The destruction of renal parenchyma is associated with suppurative/neutrophil-rich inflammation and necrosis. Evidence: TAS. Frequency: Very rare (HP:0040284). (ORPHA:68)
- Encephalomalacia (HP:0040197): Encephalomalacia is the softening or loss of brain tissue after cerebral infarction, cerebral ischemia, infection, craniocerebral trauma, or other injury. Evidence: TAS. Frequency: Very rare (HP:0040284). (ORPHA:68)
- Corneal perforation (HP:0100583): A rupture of the cornea through which a portion of the iris protrudes. Evidence: TAS. Frequency: Very rare (HP:0040284). (ORPHA:68)
- Ocular pain (HP:0200026): An unpleasant sensation characterized by physical discomfort (such as pricking, throbbing, or aching) localized to the eye. Evidence: TAS. Frequency: Very rare (HP:0040284). (ORPHA:68)
- Papule (HP:0200034): A circumscribed, solid elevation of skin with no visible fluid, varying in size from a pinhead to less than 10mm in diameter at the widest point. Evidence: TAS. Frequency: Very rare (HP:0040284). (ORPHA:68)
- Pustule (HP:0200039): A small elevation of the skin containing cloudy or purulent material usually consisting of necrotic inflammatory cells. Evidence: TAS. Frequency: Very rare (HP:0040284). (ORPHA:68)
- Skin ulcer (HP:0200042): A discontinuity of the skin exhibiting complete loss of the epidermis and often portions of the dermis and even subcutaneous fat. Evidence: TAS. Frequency: Very rare (HP:0040284). (ORPHA:68)